- Osteoporosis (HP:0000939): Osteoporosis is a systemic skeletal disease characterized by low bone density and microarchitectural deterioration of bone tissue with a consequent increase in bone fragility. According to the WHO criteria, osteoporosis is defined as a BMD that lies 2.5 standard deviations or more below the average value for young healthy adults (a T-score below -2.5 SD). Evidence: PCS. Frequency: 2/2. (PMID:19920351)
- Juvenile onset (HP:0003621): Onset of signs or symptoms of disease between the age of 5 and 15 years. Evidence: PCS. Frequency: 2/2. (PMID:19920351)
- Compression fracture (HP:4000047): A type of fracture in which the bone is crushed, causing the broken bone to be wider or flatter in appearance. Evidence: PCS. Frequency: 2/2. (PMID:19920351)
- Autosomal recessive inheritance (HP:0000007): A mode of inheritance that is observed for traits related to a gene encoded on one of the autosomes (i.e., the human chromosomes 1-22) in which a trait manifests in individuals with two pathogenic alleles, either homozygotes (two copies of the same mutant allele) or compound heterozygotes (whereby each copy of a gene has a distinct mutant allele). Evidence: PCS. (PMID:19920351)
- Recurrent fractures (HP:0002757): The repeated occurrence of bone fractures (implying an abnormally increased tendency for fracture). Evidence: PCS. Frequency: 2/2. (PMID:19920351)
- Autosomal dominant inheritance (HP:0000006): A mode of inheritance that is observed for traits related to a gene encoded on one of the autosomes (i.e., the human chromosomes 1-22) in which a trait manifests in heterozygotes. In the context of medical genetics, an autosomal dominant disorder is caused when a single copy of the mutant allele is present. Males and females are affected equally, and can both transmit the disorder with a risk of 50% for each child of inheriting the mutant allele. Evidence: TAS. (OMIM:613418)
These phenotypes are associated with the disease Bone mineral density QTL 15 (OMIM:613418).